Phenotypes associated with the disease Orofaciodigital syndrome type 14 (ORPHA:434179):
- Epispadias (HP:0000039): Epispadias is a urogenital malformation characterized by the failure of the urethral tube to tubularize on the dorsal aspect. Unlike in hypospadias, where the meatus is on the ventral aspect, children with epispadias have a wide-open urethral plate on the dorsum. It is commonly seen as a component in the spectrum of bladder exstrophy-epispadias-complex. Isolated epispadias constitutes less than 10 percent of the total cases of epispadias. Evidence: TAS. Frequency: Frequent (HP:0040282). (ORPHA:434179)
- Cleft palate (HP:0000175): Cleft palate is a developmental defect of the palate resulting from a failure of fusion of the palatine processes and manifesting as a separation of the roof of the mouth (soft and hard palate). Evidence: TAS. Frequency: Frequent (HP:0040282). (ORPHA:434179)
- Lobulated tongue (HP:0000180): Multiple indentations and/or elevations on the edge and/or surface of the tongue producing an irregular surface contour. Evidence: TAS. Frequency: Frequent (HP:0040282). (ORPHA:434179)
- Accessory oral frenulum (HP:0000191): Extra fold of tissue extending from the alveolar ridge to the inner surface of the upper or lower lip. Evidence: TAS. Frequency: Frequent (HP:0040282). (ORPHA:434179)
- Trigonocephaly (HP:0000243): Wedge-shaped, or triangular head, with the apex of the triangle at the midline of the forehead and the base of the triangle at the occiput. Evidence: TAS. Frequency: Frequent (HP:0040282). (ORPHA:434179)
- Microcephaly (HP:0000252): Head circumference below 2 standard deviations below the mean for age and gender. Evidence: TAS. Frequency: Frequent (HP:0040282). (ORPHA:434179)
- Microretrognathia (HP:0000308): A form of developmental hypoplasia of the mandible in which the mandible is mislocalised posteriorly. Evidence: TAS. Frequency: Frequent (HP:0040282). (ORPHA:434179)
- Sloping forehead (HP:0000340): Inclination of the anterior surface of the forehead from the vertical more than two standard deviations above the mean (objective); or apparently excessive posterior sloping of the forehead in a lateral view. Evidence: TAS. Frequency: Frequent (HP:0040282). (ORPHA:434179)
- Posteriorly rotated ears (HP:0000358): A type of abnormal location of the ears in which the position of the ears is characterized by posterior rotation (the superior part of the ears is rotated towards the back of the head, and the inferior part of the ears towards the front). Evidence: TAS. Frequency: Frequent (HP:0040282). (ORPHA:434179)
- Bulbous nose (HP:0000414): Increased volume and globular shape of the anteroinferior aspect of the nose. Evidence: TAS. Frequency: Frequent (HP:0040282). (ORPHA:434179)
- Webbed neck (HP:0000465): Pterygium colli is a congenital skin fold that runs along the sides of the neck down to the shoulders. It involves an ectopic fibrotic facial band superficial to the trapezius muscle. Excess hair-bearing skin is also present and extends down the cervical region well beyond the normal hairline. Evidence: TAS. Frequency: Frequent (HP:0040282). (ORPHA:434179)
- Short neck (HP:0000470): Diminished length of the neck. Evidence: TAS. Frequency: Frequent (HP:0040282). (ORPHA:434179)
- Retinal coloboma (HP:0000480): A notch or cleft of the retina or choroid, located vertically below the optic disc. Evidence: TAS. Frequency: Frequent (HP:0040282). (ORPHA:434179)
- Telecanthus (HP:0000506): Distance between the inner canthi more than two standard deviations above the mean (objective); or, apparently increased distance between the inner canthi. Evidence: TAS. Frequency: Frequent (HP:0040282). (ORPHA:434179)
- Upslanted palpebral fissure (HP:0000582): The palpebral fissure inclination is more than two standard deviations above the mean for age (objective); or, the inclination of the palpebral fissure is greater than typical for age. Evidence: TAS. Frequency: Frequent (HP:0040282). (ORPHA:434179)
- Postaxial hand polydactyly (HP:0001162): Supernumerary digits located at the ulnar side of the hand (that is, on the side with the fifth finger). Evidence: TAS. Frequency: Frequent (HP:0040282). (ORPHA:434179)
- Intellectual disability (HP:0001249): The term intellectual disability or intellectual developmental disorder is used to describe significantly sub-average intellectual and adaptive functioning based on clinical assessment and as measured by individually administered, appropriately normed, standardized and validated tests of intellectual functioning and adaptive behavior, with onset during the developmental period from infancy through adolescence. Evidence: TAS. Frequency: Frequent (HP:0040282). (ORPHA:434179)
- Hypotonia (HP:0001252): Hypotonia is an abnormally low muscle tone (the amount of tension or resistance to movement in a muscle). Even when relaxed, muscles have a continuous and passive partial contraction which provides some resistance to passive stretching. Hypotonia thus manifests as diminished resistance to passive stretching. Hypotonia is not the same as muscle weakness, although the two conditions can co-exist. Evidence: TAS. Frequency: Frequent (HP:0040282). (ORPHA:434179)
- Global developmental delay (HP:0001263): A delay in the achievement of motor or mental milestones in the domains of development of a child, including motor skills, speech and language, cognitive skills, and social and emotional skills. This term should only be used to describe children younger than five years of age. Evidence: TAS. Frequency: Frequent (HP:0040282). (ORPHA:434179)
- Dandy-Walker malformation (HP:0001305): A congenital brain malformation typically characterized by incomplete formation of the cerebellar vermis, dilation of the fourth ventricle, and enlargement of the posterior fossa. In layman's terms, Dandy Walker malformation is a cyst in the cerebellum (typically symmetrical) that is involved with the fourth ventricle. This may interfere with the ability to drain cerebrospinal fluid from the brain, resulting in hydrocephalus. Dandy Walker cysts are formed during early embryonic development, while the brain forms. The cyst in the cerebellum typically has several blood vessels running through it connecting to the brain, thereby prohibiting surgical removal. Evidence: TAS. Frequency: Frequent (HP:0040282). (ORPHA:434179)
- Partial agenesis of the corpus callosum (HP:0001338): A partial failure of the development of the corpus callosum. Evidence: TAS. Frequency: Frequent (HP:0040282). (ORPHA:434179)
- Ventricular septal defect (HP:0001629): A hole between the two bottom chambers (ventricles) of the heart. The defect is centered around the most superior aspect of the ventricular septum. Evidence: TAS. Frequency: Frequent (HP:0040282). (ORPHA:434179)
- Patent ductus arteriosus (HP:0001643): In utero, the ductus arteriosus (DA) serves to divert ventricular output away from the lungs and toward the placenta by connecting the main pulmonary artery to the descending aorta. A patent ductus arteriosus (PDA) in the first 3 days of life is a physiologic shunt in healthy term and preterm newborn infants, and normally is substantially closed within about 24 hours after bith and completely closed after about three weeks. Failure of physiologcal closure is referred to a persistent or patent ductus arteriosus (PDA). Depending on the degree of left-to-right shunting, PDA can have clinical consequences. Evidence: TAS. Frequency: Frequent (HP:0040282). (ORPHA:434179)
- Postaxial foot polydactyly (HP:0001830): Polydactyly of the foot most commonly refers to the presence of six toes on one foot. Postaxial polydactyly affects the lateral ray and the duplication may range from a well-formed articulated digit to a rudimentary digit. Evidence: TAS. Frequency: Frequent (HP:0040282). (ORPHA:434179)
- Abnormal facial shape (HP:0001999): An abnormal morphology (form) of the face or its components. Evidence: TAS. Frequency: Frequent (HP:0040282). (ORPHA:434179)
- Hypoplasia of the corpus callosum (HP:0002079): Underdevelopment of the corpus callosum. Evidence: TAS. Frequency: Frequent (HP:0040282). (ORPHA:434179)
- Dilated fourth ventricle (HP:0002198): An abnormal dilatation of the fourth cerebral ventricle. Evidence: TAS. Frequency: Frequent (HP:0040282). (ORPHA:434179)
- Molar tooth sign on MRI (HP:0002419): An abnormal appearance of the midbrain in axial magnetic resonance imaging in which the elongated superior cerebellar peduncles give the midbrain an appearance reminiscent of a molar or wisdom tooth. Evidence: TAS. Frequency: Frequent (HP:0040282). (ORPHA:434179)
- Dilated third ventricle (HP:0007082): An increase in size of the third ventricle. Evidence: TAS. Frequency: Frequent (HP:0040282). (ORPHA:434179)
- Periventricular heterotopia (HP:0007165): A form of gray matter heterotopia were the mislocalized gray matter is typically located periventricularly, also sometimes called subependymal heterotopia. Periventricular means beside the ventricles. This is by far the most common location for heterotopia. Subependymal heterotopia present in a wide array of variations. There can be a small single node or a large number of nodes, can exist on either or both sides of the brain at any point along the higher ventricle margins, can be small or large, single or multiple, and can form a small node or a large wavy or curved mass. Evidence: TAS. Frequency: Frequent (HP:0040282). (ORPHA:434179)
- Bilateral cryptorchidism (HP:0008689): Absence of both testes from the scrotum owing to failure of the testis or testes to descend through the inguinal canal to the scrotum. Evidence: TAS. Frequency: Frequent (HP:0040282). (ORPHA:434179)
- Aplasia of the epiglottis (HP:0008753): Absence of the epiglottis. Evidence: TAS. Frequency: Frequent (HP:0040282). (ORPHA:434179)
- Deviation of the hallux (HP:0010051): Displacement of the big toe from its normal position. Evidence: TAS. Frequency: Frequent (HP:0040282). (ORPHA:434179)
- Broad hallux (HP:0010055): Visible increase in width of the hallux without an increase in the dorso-ventral dimension. Evidence: TAS. Frequency: Frequent (HP:0040282). (ORPHA:434179)
- Duplication of phalanx of hallux (HP:0010066): Partial or complete duplication of one or more phalanx of big toe. Evidence: TAS. Frequency: Frequent (HP:0040282). (ORPHA:434179)
- Bifid tongue (HP:0010297): Tongue with a median apical indentation or fork. Evidence: TAS. Frequency: Frequent (HP:0040282). (ORPHA:434179)
- Sleep apnea (HP:0010535): An intermittent cessation of airflow at the mouth and nose during sleep is known as sleep apnea. Apneas that last at least 10 seconds are considered significant, but individuals with sleep apnea may experience apneas lasting from 20 seconds up to 2 or 3 minutes. Patients may have up to 15 events per hour of sleep. Evidence: TAS. Frequency: Frequent (HP:0040282). (ORPHA:434179)
- Supernumerary tooth (HP:0011069): The presence of one or more teeth additional to the normal number. Evidence: TAS. Frequency: Frequent (HP:0040282). (ORPHA:434179)
- Gastrostomy tube feeding in infancy (HP:0011471): Feeding problem necessitating gastrostomy tube feeding. Evidence: TAS. Frequency: Frequent (HP:0040282). (ORPHA:434179)
- Hamartoma of tongue (HP:0011802): A benign (noncancerous) tumorlike malformation made up of an abnormal mixture of cells and tissues that originates in the tongue. Evidence: TAS. Frequency: Frequent (HP:0040282). (ORPHA:434179)
- Abnormal myelination (HP:0012447): Any anomaly in the process by which myelin sheaths are formed and maintained around neurons. Evidence: TAS. Frequency: Frequent (HP:0040282). (ORPHA:434179)
- Open operculum (HP:0100954): Underdevelopment of the operculum. Evidence: TAS. Frequency: Frequent (HP:0040282). (ORPHA:434179)